- Supravalvular aortic stenosis (HP:0004381): A pathological narrowing in the region above the aortic valve associated with restricted left ventricular outflow. Evidence: TAS. Frequency: Very frequent (HP:0040281). (ORPHA:3193)
- Arrhythmia (HP:0011675): Any cardiac rhythm other than the normal sinus rhythm. Such a rhythm may be either of sinus or ectopic origin and either regular or irregular. An arrhythmia may be due to a disturbance in impulse formation or conduction or both. Evidence: TAS. Frequency: Very frequent (HP:0040281). (ORPHA:3193)
- Syncope (HP:0001279): A transient loss of consciousness (i.e., characterized by a rapid onset, a short duration, and a spontaneous and complete recovery) due to cerebral hypoperfusion. Evidence: TAS. Frequency: Frequent (HP:0040282). (ORPHA:3193)
- Angina pectoris (HP:0001681): Paroxysmal chest pain that occurs with exertion or stress and is related to myocardial ischemia. Evidence: TAS. Frequency: Frequent (HP:0040282). (ORPHA:3193)
- Dyspnea (HP:0002094): Difficult or labored breathing. Dyspnea is a subjective feeling only the patient can rate, e.g., on a Borg scale. Evidence: TAS. Frequency: Frequent (HP:0040282). (ORPHA:3193)
- Systolic heart murmur (HP:0031664): A heart murmur limited to systole, i.e., between the first and second heart sounds S1 and S2. Evidence: TAS. Frequency: Frequent (HP:0040282). (ORPHA:3193)
- Hypertension (HP:0000822): The presence of chronic increased pressure in the systemic arterial system. Evidence: TAS. Frequency: Occasional (HP:0040283). (ORPHA:3193)
These phenotypes are associated with the disease Supravalvular aortic stenosis (ORPHA:3193).